- Strabismus (HP:0000486): A misalignment of the eyes so that the visual axes deviate from bifoveal fixation. The classification of strabismus may be based on a number of features including the relative position of the eyes, whether the deviation is latent or manifest, intermittent or constant, concomitant or otherwise and according to the age of onset and the relevance of any associated refractive error. Evidence: PCS. Frequency: 1/10. (PMID:31928709)
- Long philtrum (HP:0000343): Distance between nasal base and midline upper lip vermilion border more than 2 SD above the mean. Alternatively, an apparently increased distance between nasal base and midline upper lip vermilion border. Evidence: PCS. Frequency: 4/9. (PMID:31928709)
- Seizure (HP:0001250): A seizure is an intermittent abnormality of nervous system physiology characterized by a transient occurrence of signs and/or symptoms due to abnormal excessive or synchronous neuronal activity in the brain. Evidence: PCS. Frequency: 4/12. (PMID:31928709)
- Generalized hypotonia (HP:0001290): Generalized muscular hypotonia (abnormally low muscle tone). Evidence: PCS. Frequency: 9/12. (PMID:31928709)
- Delayed fine motor development (HP:0010862): A type of motor delay characterized by a delay in acquiring the ability to control the fingers and hands. Evidence: PCS. Frequency: 9/10. (PMID:31928709)
- Depression (HP:0000716): Frequently experiencing feelings of being down, miserable, and/or hopeless; struggling to recover from these moods; having a pessimistic outlook on the future; feeling a pervasive sense of shame; having a low self-worth; experiencing thoughts of suicide and engaging in suicidal behavior. Evidence: PCS. Frequency: 1/6. (PMID:31928709)
- Nystagmus (HP:0000639): Rhythmic, involuntary oscillations of one or both eyes related to abnormality in fixation, conjugate gaze, or vestibular mechanisms. Evidence: PCS. Frequency: 2/10. (PMID:31928709)
- Ventricular septal defect (HP:0001629): A hole between the two bottom chambers (ventricles) of the heart. The defect is centered around the most superior aspect of the ventricular septum. Evidence: PCS. Frequency: 1/7. (PMID:31928709)
- Anxiety (HP:0000739): Intense feelings of nervousness, tension, or panic often arise in response to interpersonal stresses. There is worry about the negative effects of past unpleasant experiences and future negative possibilities. Individuals may feel fearful, apprehensive, or threatened by uncertainty, and they may also have fears of falling apart or losing control. Evidence: PCS. Frequency: 3/6. (PMID:31928709)
- Periventricular leukomalacia (HP:0006970): Periventricular leukomalacia is characterized by diffuse injury of deep cerebral white matter, accompanied in its most severe form by focal necrosis. The neuropathologic hallmarks of PVL are microglial activation and focal and diffuse periventricular depletion of premyelinating oligodendroglia. Evidence: PCS. Frequency: 1/8. (PMID:31928709)
- Feeding difficulties in infancy (HP:0008872): Impaired feeding performance of an infant as manifested by difficulties such as weak and ineffective sucking, brief bursts of sucking, and falling asleep during sucking. There may be difficulties with chewing or maintaining attention. Evidence: PCS. Frequency: 4/7. (PMID:31928709)
- Broad forehead (HP:0000337): Width of the forehead or distance between the frontotemporales is more than two standard deviations above the mean (objective); or apparently increased distance between the two sides of the forehead. Evidence: PCS. (PMID:31928709)
- Ventriculomegaly (HP:0002119): An increase in size of the ventricular system of the brain. Evidence: PCS. Frequency: 1/8. (PMID:31928709)
- High palate (HP:0000218): Height of the palate more than 2 SD above the mean (objective) or palatal height at the level of the first permanent molar more than twice the height of the teeth (subjective). Evidence: PCS. Frequency: 3/8. (PMID:31928709)
- Protruding ear (HP:0000411): Angle formed by the plane of the ear and the mastoid bone greater than the 97th centile for age (objective); or, outer edge of the helix more than 2 cm from the mastoid at the point of maximum distance (objective). Evidence: PCS. Frequency: 4/8. (PMID:31928709)
- Macrocephaly (HP:0000256): Occipitofrontal (head) circumference greater than 97th centile compared to appropriate, age matched, sex-matched normal standards. Alternatively, a apparently increased size of the cranium. Evidence: PCS. Frequency: 2/11. Onset: Infantile onset (HP:0003593). (PMID:31928709)
- Pes planus (HP:0001763): A foot where the longitudinal arch of the foot is in contact with the ground or floor when the individual is standing; or, in a patient lying supine, a foot where the arch is in contact with the surface of a flat board pressed against the sole of the foot by the examiner with a pressure similar to that expected from weight bearing; or, the height of the arch is reduced. Evidence: PCS. Frequency: 1/7. (PMID:31928709)
- Intellectual disability (HP:0001249): The term intellectual disability or intellectual developmental disorder is used to describe significantly sub-average intellectual and adaptive functioning based on clinical assessment and as measured by individually administered, appropriately normed, standardized and validated tests of intellectual functioning and adaptive behavior, with onset during the developmental period from infancy through adolescence. Evidence: PCS. Frequency: 6/7. (PMID:31928709)
- Facial hypotonia (HP:0000297): Reduced muscle tone of a muscle that is innervated by the facial nerve (the seventh cranial nerve). Evidence: PCS. Frequency: 4/8. (PMID:31928709)
- Microcephaly (HP:0000252): Head circumference below 2 standard deviations below the mean for age and gender. Evidence: PCS. Frequency: 1/11. (PMID:31928709)
- Hip dysplasia (HP:0001385): The presence of developmental dysplasia of the hip. Evidence: PCS. Frequency: 1/7. (PMID:31928709)
- Delayed speech and language development (HP:0000750): A degree of language development that is significantly below the norm for a child of a specified age. Evidence: PCS. Frequency: 9/9. (PMID:31928709)
- EEG abnormality (HP:0002353): Abnormality observed by electroencephalogram (EEG), which is used to record of the brain's spontaneous electrical activity from multiple electrodes placed on the scalp. Evidence: PCS. Frequency: 4/8. (PMID:31928709)
- Cardiomegaly (HP:0001640): Increased size of the heart, clinically defined as an increased transverse diameter of the cardiac silhouette that is greater than or equal to 50% of the transverse diameter of the chest (increased cardiothoracic ratio) on a posterior-anterior projection of a chest radiograph or a computed tomography. Evidence: PCS. Frequency: 1/7. (PMID:31928709)
- Long face (HP:0000276): Facial height (length) is more than 2 standard deviations above the mean (objective); or, an apparent increase in the height (length) of the face (subjective). Evidence: PCS. Frequency: 5/10. (PMID:31928709)
- Joint hypermobility (HP:0001382): The capability that a joint (or a group of joints) has to move, passively and/or actively, beyond normal limits along physiological axes. Evidence: PCS. Frequency: 1/7. (PMID:31928709)
- Open mouth (HP:0000194): A facial appearance characterized by a permanently or nearly permanently opened mouth. Evidence: PCS. Frequency: 4/8. (PMID:31928709)
- Global developmental delay (HP:0001263): A delay in the achievement of motor or mental milestones in the domains of development of a child, including motor skills, speech and language, cognitive skills, and social and emotional skills. This term should only be used to describe children younger than five years of age. Evidence: PCS. Frequency: 11/11. (PMID:31928709)
- Delayed gross motor development (HP:0002194): A type of motor delay characterized by a delay in acquiring the ability to control the large muscles of the body for walking, running, sitting, and crawling. Evidence: PCS. Frequency: 10/10. (PMID:31928709)
- Extra-axial cerebrospinal fluid accumulation (HP:0012510): An increased amount of cerebrospinal fluid (CSF) in the subarachnoid space. Evidence: PCS. Frequency: 2/8. (PMID:31928709)
- Reduced social responsiveness (HP:0012760): A reduced ability to participate in the back-and-forth flow of social interaction appropriate to culture and developmental level, which is normally characterized by an influence of the behavior of one person on the behavior of another person. This results in difficulty interacting with others through emotional, physical, or verbal communication. Evidence: PCS. Frequency: 6/6. (PMID:31928709)
- Autistic behavior (HP:0000729): Persistent deficits in social interaction and communication and interaction as well as a markedly restricted repertoire of activity and interest as well as repetitive patterns of behavior. Evidence: PCS. Frequency: 5/6. (PMID:31928709)
- Ptosis (HP:0000508): The upper eyelid margin is positioned 3 mm or more lower than usual and covers the superior portion of the iris (objective); or, the upper lid margin obscures at least part of the pupil (subjective). Evidence: PCS. Frequency: 1/10. (PMID:31928709)
- Autosomal recessive inheritance (HP:0000007): A mode of inheritance that is observed for traits related to a gene encoded on one of the autosomes (i.e., the human chromosomes 1-22) in which a trait manifests in individuals with two pathogenic alleles, either homozygotes (two copies of the same mutant allele) or compound heterozygotes (whereby each copy of a gene has a distinct mutant allele). Evidence: PCS. (PMID:31928709)
- High forehead (HP:0000348): An abnormally increased height of the forehead. Evidence: PCS. (PMID:31928709)
- Accelerated skeletal maturation (HP:0005616): An abnormally increased rate of skeletal maturation. Accelerated skeletal maturation can be diagnosed on the basis of an estimation of the bone age from radiographs of specific bones in the human body. Evidence: PCS. Frequency: 1/7. (PMID:31928709)
- Attention deficit hyperactivity disorder (HP:0007018): Attention deficit hyperactivity disorder (ADHD) manifests at age 2-3 years or by first grade at the latest. The main symptoms are distractibility, impulsivity, hyperactivity, and often trouble organizing tasks and projects, difficulty going to sleep, and social problems from being aggressive, loud, or impatient. Evidence: PCS. Frequency: 3/6. (PMID:31928709)
- Lacrimal duct stenosis (HP:0007678): Narrowing of a tear duct (lacrimal duct). Evidence: PCS. Frequency: 1/10. (PMID:31928709)
- Autosomal dominant inheritance (HP:0000006): A mode of inheritance that is observed for traits related to a gene encoded on one of the autosomes (i.e., the human chromosomes 1-22) in which a trait manifests in heterozygotes. In the context of medical genetics, an autosomal dominant disorder is caused when a single copy of the mutant allele is present. Males and females are affected equally, and can both transmit the disorder with a risk of 50% for each child of inheriting the mutant allele. Evidence: PCS. (PMID:31928709)
- Brachycephaly (HP:0000248): An abnormality of skull shape characterized by a decreased anterior-posterior diameter. That is, a cephalic index greater than 81%. Alternatively, an apparently shortened anteroposterior dimension (length) of the head compared to width. Evidence: PCS. Frequency: 4/8. (PMID:31928709)
These phenotypes are associated with the disease Beck-Fahrner syndrome (OMIM:618798).